Phenotypes associated with the disease lissencephaly type 1 due to doublecortin gene mutation (OMIM:300067):
- Axial hypotonia (HP:0008936): Muscular hypotonia (abnormally low muscle tone) affecting the musculature of the trunk. Evidence: IEA. (OMIM:300067)
- Micropenis (HP:0000054): Abnormally small penis. At birth, the normal penis is about 3 cm (stretched length from pubic tubercle to tip of penis) with micropenis less than 2.0-2.5 cm. Evidence: IEA. (OMIM:300067)
- Seizure (HP:0001250): A seizure is an intermittent abnormality of nervous system physiology characterized by a transient occurrence of signs and/or symptoms due to abnormal excessive or synchronous neuronal activity in the brain. Evidence: PCS. (OMIM:300067)
- Dysarthria (HP:0001260): Dysarthric speech is a general description referring to a neurological speech disorder characterized by poor articulation. Depending on the involved neurological structures, dysarthria may be further classified as spastic, flaccid, ataxic, hyperkinetic and hypokinetic, or mixed. Evidence: IEA. (OMIM:300067)
- Agenesis of corpus callosum (HP:0001274): Absence of the corpus callosum as a result of the failure of the corpus callosum to develop, which can be the result of a failure in any one of the multiple steps of callosal development including cellular proliferation and migration, axonal growth or glial patterning at the midline. Evidence: IEA. (OMIM:300067)
- Ataxia (HP:0001251): Ataxia refers to impaired coordination of voluntary muscle movement. Cerebellar ataxia refers to ataxia due to dysfunction of the cerebellum. This causes a variety of elementary neurological deficits including asynergy (lack of coordination between muscles, limbs and joints), dysmetria (lack of ability to judge distances that can lead to under- or overshoot in grasping movements), and dysdiadochokinesia (inability to perform rapid movements requiring antagonizing muscle groups to be switched on and off repeatedly). Evidence: IEA. (OMIM:300067)
- Infantile onset (HP:0003593): Onset of signs or symptoms of disease between 28 days to one year of life. Evidence: TAS. (OMIM:300067)
- Agyria (HP:0031882): A congenital abnormality of the cerebral hemisphere characterized by lack of gyrations (convolutions) of the cerebral cortex. Agyria is defined as cortical regions lacking gyration with sulci great than 3 cm apart and cerebral cortex thicker than 5 mm. Evidence: IEA. (OMIM:300067)
- Gray matter heterotopia (HP:0002282): Heterotopia or neuronal heterotopia are macroscopic clusters of misplaced neurons (gray matter), most often situated along the ventricular walls or within the subcortical white matter. Evidence: IEA. (OMIM:300067)
- Motor delay (HP:0001270): A type of Developmental delay characterized by a delay in acquiring motor skills. Evidence: IEA. (OMIM:300067)
- Nystagmus (HP:0000639): Rhythmic, involuntary oscillations of one or both eyes related to abnormality in fixation, conjugate gaze, or vestibular mechanisms. Evidence: IEA. (OMIM:300067)
- Typified by incomplete penetrance (HP:0003829): Description of conditions in which not all individuals with a given genotype exhibit the disease. Penetrance is the proportion that develop disease given a lifespan of 80 years. Evidence: IEA. (OMIM:300067)
- Lissencephaly (HP:0001339): A spectrum of malformations of cortical development caused by insufficient neuronal migration that subsumes the terms agyria, pachygyria and subcortical band heterotopia. See also neuropathological definitions for 2-, 3-, and 4-layered lissencephaly. Evidence: IEA. (OMIM:300067)
- Postnatal growth retardation (HP:0008897): Slow or limited growth after birth. Evidence: PCS. (OMIM:300067)
- X-linked inheritance (HP:0001417): A mode of inheritance that is observed for traits related to a gene encoded on the X chromosome. Evidence: IEA. (OMIM:300067)
- Pachygyria (HP:0001302): Pachygyria is a malformation of cortical development with abnormally wide gyri with sulci 1,5-3 cm apart and abnormally thick cortex measuring more than 5 mm (radiological definition). See also neuropathological definitions for 2-, 3-, and 4-layered lissencephaly. Evidence: IEA. (OMIM:300067)
- Death in infancy (HP:0001522): Death within the first 24 months of life. Evidence: IEA. (OMIM:300067)
- Spasticity (HP:0001257): A motor disorder characterized by a velocity-dependent increase in tonic stretch reflexes with increased muscle tone, exaggerated (hyperexcitable) tendon reflexes. Evidence: IEA. (OMIM:300067)
- Intellectual disability (HP:0001249): The term intellectual disability or intellectual developmental disorder is used to describe significantly sub-average intellectual and adaptive functioning based on clinical assessment and as measured by individually administered, appropriately normed, standardized and validated tests of intellectual functioning and adaptive behavior, with onset during the developmental period from infancy through adolescence. Evidence: PCS. (OMIM:300067)